Phenotypes associated with the disease Bardet-Biedl syndrome 18 (OMIM:615995):
- Stage 5 chronic kidney disease (HP:0003774): A degree of kidney failure severe enough to require dialysis or kidney transplantation for survival characterized by a severe reduction in glomerular filtration rate (less than 15 ml/min/1.73 m2) and other manifestations including increased serum creatinine. Evidence: PCS. Frequency: 1/1. Onset: Middle age onset (HP:0003596). (PMID:24026985)
- Brachydactyly (HP:0001156): Digits that appear disproportionately short compared to the hand/foot. The word brachydactyly is used here to describe a series distinct patterns of shortened digits (brachydactyly types A-E). This is the sense used here. Evidence: PCS. Frequency: 1/1. (PMID:24026985)
- Cataract (HP:0000518): A cataract is an opacity or clouding that develops in the crystalline lens of the eye or in its capsule. Evidence: PCS. Frequency: 1/1. (PMID:24026985)
- Renal insufficiency (HP:0000083): A reduction in the level of performance of the kidneys in areas of function comprising the concentration of urine, removal of wastes, the maintenance of electrolyte balance, homeostasis of blood pressure, and calcium metabolism. Evidence: PCS. Frequency: 1/1. (PMID:24026985)
- Autosomal recessive inheritance (HP:0000007): A mode of inheritance that is observed for traits related to a gene encoded on one of the autosomes (i.e., the human chromosomes 1-22) in which a trait manifests in individuals with two pathogenic alleles, either homozygotes (two copies of the same mutant allele) or compound heterozygotes (whereby each copy of a gene has a distinct mutant allele). Evidence: PCS. (PMID:24026985)
- Rod-cone dystrophy (HP:0000510): An inherited retinal disease subtype in which the rod photoreceptors appear to be more severely affected than the cone photoreceptors. Typical presentation is with nyctalopia (due to rod dysfunction) followed by loss of mid-peripheral field of vision, which gradually extends and leaves many patients with a small central island of vision due to the preservation of macular cones. Evidence: PCS. Frequency: 1/1. (PMID:24026985)
- Obesity (HP:0001513): Accumulation of substantial excess body fat. Evidence: PCS. Frequency: 1/1. (PMID:24026985)
- Retinal dystrophy (HP:0000556): Retinal dystrophy is an abnormality of the retina associated with a hereditary process. Retinal dystrophies are defined by their predominantly monogenic inheritance and they are frequently associated with loss or dysfunction of photoreceptor cells as a primary or secondary event. Evidence: PCS. Frequency: 1/1. (PMID:24026985)
- Intellectual disability (HP:0001249): The term intellectual disability or intellectual developmental disorder is used to describe significantly sub-average intellectual and adaptive functioning based on clinical assessment and as measured by individually administered, appropriately normed, standardized and validated tests of intellectual functioning and adaptive behavior, with onset during the developmental period from infancy through adolescence. Evidence: PCS. Frequency: 1/1. (PMID:24026985)